Phenotypes associated with the disease TAFRO syndrome (ORPHA:457077):
- Hepatosplenomegaly (HP:0001433): Simultaneous enlargement of the liver and spleen. Evidence: TAS. Frequency: Very frequent (HP:0040281). (ORPHA:457077)
- Thrombocytopenia (HP:0001873): A reduction in the number of circulating thrombocytes. Evidence: TAS. Frequency: Very frequent (HP:0040281). (ORPHA:457077)
- Lymphadenopathy (HP:0002716): Enlargement (swelling) of a lymph node. Evidence: TAS. Frequency: Very frequent (HP:0040281). (ORPHA:457077)
- Elevated circulating C-reactive protein concentration (HP:0011227): The concentration of C-reactive protein in the blood circulation is above the upper limit of normal. Evidence: TAS. Frequency: Very frequent (HP:0040281). (ORPHA:457077)
- Anasarca (HP:0012050): An extreme form of generalized edema with widespread and massive edema due to effusion of fluid into the extracellular space. Evidence: TAS. Frequency: Very frequent (HP:0040281). (ORPHA:457077)
- Renal insufficiency (HP:0000083): A reduction in the level of performance of the kidneys in areas of function comprising the concentration of urine, removal of wastes, the maintenance of electrolyte balance, homeostasis of blood pressure, and calcium metabolism. Evidence: TAS. Frequency: Frequent (HP:0040282). (ORPHA:457077)
- Ascites (HP:0001541): Accumulation of fluid in the peritoneal cavity (between the layers of the peritoneum that lines the abdomen). Evidence: TAS. Frequency: Frequent (HP:0040282). (ORPHA:457077)
- Splenomegaly (HP:0001744): Abnormal increased size of the spleen. Evidence: TAS. Frequency: Frequent (HP:0040282). (ORPHA:457077)
- Anemia (HP:0001903): A reduction in erythrocytes volume or hemoglobin concentration. Evidence: TAS. Frequency: Frequent (HP:0040282). (ORPHA:457077)
- Fever (HP:0001945): Body temperature elevated above the normal range. Evidence: TAS. Frequency: Frequent (HP:0040282). (ORPHA:457077)
- Increased total leukocyte count (HP:0001974): An abnormal increase in the number of leukocytes in the blood. Evidence: TAS. Frequency: Frequent (HP:0040282). (ORPHA:457077)
- Pleural effusion (HP:0002202): The presence of an excessive amount of fluid in the pleural cavity. Evidence: TAS. Frequency: Frequent (HP:0040282). (ORPHA:457077)
- Hepatomegaly (HP:0002240): Abnormally increased size of the liver. Evidence: TAS. Frequency: Frequent (HP:0040282). (ORPHA:457077)
- Elevated circulating alkaline phosphatase concentration (HP:0003155): Abnormally increased serum levels of alkaline phosphatase activity. Evidence: TAS. Frequency: Frequent (HP:0040282). (ORPHA:457077)
- Increased megakaryocyte count (HP:0005513): Increased megakaryocyte number, i.e., of platelet precursor cells, present in the bone marrow. Evidence: TAS. Frequency: Frequent (HP:0040282). (ORPHA:457077)
- Myelofibrosis (HP:0011974): Replacement of bone marrow by fibrous tissue. Evidence: TAS. Frequency: Frequent (HP:0040282). (ORPHA:457077)
- Increased circulating interleukin 6 concentration (HP:0030783): The concentration of interleukin-6 in the blood circulation is above the upper limit of normal. Evidence: TAS. Frequency: Frequent (HP:0040282). (ORPHA:457077)
- Elevated vascular endothelial growth factor level (HP:0031052): Increased blood concentration of vascular endothelial growth factor (VEGF). Evidence: TAS. Frequency: Frequent (HP:0040282). (ORPHA:457077)
- Reduced circulating lactate dehydrogenase concentration (HP:0045041): Concentration of lactate dehydrogenase in the blood circulation below the lower limit of normal. Evidence: TAS. Frequency: Occasional (HP:0040283). (ORPHA:457077)
Not associated with this disease:
- Neoplasm (HP:0002664): An organ or organ-system abnormality that consists of uncontrolled autonomous cell-proliferation which can occur in any part of the body as a benign or malignant neoplasm (tumor). Evidence: TAS. (ORPHA:457077)
- Autoimmunity (HP:0002960): The occurrence of an immune reaction against the organism's own cells or tissues. Evidence: TAS. (ORPHA:457077)
- Hemophagocytosis (HP:0012156): Phagocytosis by macrophages of erythrocytes, leukocytes, platelets, and their precursors in bone marrow and other tissues. Evidence: TAS. (ORPHA:457077)
- Severe viral infection (HP:0031691): An unusually severe viral infection. Evidence: TAS. (ORPHA:457077)
- Pulmonary tuberculosis (HP:0032262): A lung infection by Mycobacterium tuberculosis a slightly curved non-motile, aerobic, non-capsulated and non-spore forming strains of mycobacteria. Evidence: TAS. (ORPHA:457077)
- Polyclonal elevation of circulating IgG concentration (HP:0032288): An increase in polyclonal immunoglobulins resulting from many different plasma cells. On serum electrophoresis, a polyclonal gammopathy is characterized by a broad diffuse band with one or more heavy chains and kappa and lambda light chains. Evidence: TAS. (ORPHA:457077)